Phenotypes associated with the disease 22q11.2 deletion syndrome (ORPHA:567):
- Joint hypermobility (HP:0001382): The capability that a joint (or a group of joints) has to move, passively and/or actively, beyond normal limits along physiological axes. Evidence: TAS. Frequency: Occasional (HP:0040283). (ORPHA:567)
- Abnormal T cell physiology (HP:0011840): A functional anomaly of T cells. Evidence: TAS. Frequency: Frequent (HP:0040282). (ORPHA:567)
- Cleft palate (HP:0000175): Cleft palate is a developmental defect of the palate resulting from a failure of fusion of the palatine processes and manifesting as a separation of the roof of the mouth (soft and hard palate). Evidence: TAS. Frequency: Very frequent (HP:0040281). (ORPHA:567)
- Epicanthus (HP:0000286): A fold of skin starting above the medial aspect of the upper eyelid and arching downward to cover, pass in front of and lateral to the medial canthus. Evidence: TAS. Frequency: Very frequent (HP:0040281). (ORPHA:567)
- Low-set ears (HP:0000369): Upper insertion of the ear to the scalp below an imaginary horizontal line drawn between the inner canthi of the eye and extending posteriorly to the ear. Evidence: TAS. Frequency: Very frequent (HP:0040281). (ORPHA:567)
- Conductive hearing impairment (HP:0000405): An abnormality of vibrational conductance of sound to the inner ear leading to impairment of sensory perception of sound. Evidence: TAS. Frequency: Very frequent (HP:0040281). (ORPHA:567)
- Bulbous nose (HP:0000414): Increased volume and globular shape of the anteroinferior aspect of the nose. Evidence: TAS. Frequency: Very frequent (HP:0040281). (ORPHA:567)
- Prominent nasal bridge (HP:0000426): Anterior positioning of the nasal root in comparison to the usual positioning for age. Evidence: TAS. Frequency: Very frequent (HP:0040281). (ORPHA:567)
- Wide nasal bridge (HP:0000431): Increased breadth of the nasal bridge (and with it, the nasal root). Evidence: TAS. Frequency: Very frequent (HP:0040281). (ORPHA:567)
- Telecanthus (HP:0000506): Distance between the inner canthi more than two standard deviations above the mean (objective); or, apparently increased distance between the inner canthi. Evidence: TAS. Frequency: Very frequent (HP:0040281). (ORPHA:567)
- Upslanted palpebral fissure (HP:0000582): The palpebral fissure inclination is more than two standard deviations above the mean for age (objective); or, the inclination of the palpebral fissure is greater than typical for age. Evidence: TAS. Frequency: Very frequent (HP:0040281). (ORPHA:567)
- Abnormality of the pharynx (HP:0000600): An anomaly of the pharynx, i.e., of the tubular structure extending from the base of the skull superiorly to the esophageal inlet inferiorly. Evidence: TAS. Frequency: Very frequent (HP:0040281). (ORPHA:567)
- Hypoplasia of the thymus (HP:0000778): Underdevelopment of the thymus. Evidence: TAS. Frequency: Very frequent (HP:0040281). (ORPHA:567)
- Hypotonia (HP:0001252): Hypotonia is an abnormally low muscle tone (the amount of tension or resistance to movement in a muscle). Even when relaxed, muscles have a continuous and passive partial contraction which provides some resistance to passive stretching. Hypotonia thus manifests as diminished resistance to passive stretching. Hypotonia is not the same as muscle weakness, although the two conditions can co-exist. Evidence: TAS. Frequency: Very frequent (HP:0040281). (ORPHA:567)
- Hypernasal speech (HP:0001611): A type of speech characterized by the presence of an abnormally increased nasal airflow during speech associated with structural abnormality of the nasal passages. Evidence: TAS. Frequency: Very frequent (HP:0040281). (ORPHA:567)
- Ventricular septal defect (HP:0001629): A hole between the two bottom chambers (ventricles) of the heart. The defect is centered around the most superior aspect of the ventricular septum. Evidence: TAS. Frequency: Very frequent (HP:0040281). (ORPHA:567)
- Atrial septal defect (HP:0001631): Atrial septal defect (ASD) is a congenital abnormality of the interatrial septum that enables blood flow between the left and right atria via the interatrial septum. Evidence: TAS. Frequency: Very frequent (HP:0040281). (ORPHA:567)
- Tetralogy of Fallot (HP:0001636): A congenital cardiac malformation comprising pulmonary stenosis, overriding aorta, ventricular septum defect, and right ventricular hypertrophy. The diagnosis of TOF is made if at least three of the four above mentioned features are present. Evidence: TAS. Frequency: Very frequent (HP:0040281). (ORPHA:567)
- Abnormal pulmonary valve morphology (HP:0001641): Any structural abnormality of the pulmonary valve. Evidence: TAS. Frequency: Very frequent (HP:0040281). (ORPHA:567)
- Truncus arteriosus (HP:0001660): A single arterial trunk arises from the cardiac mass. The pulmonary arteries, aorta and coronary arteries arise from this single trunk with no evidence of another outflow tract. Evidence: TAS. Frequency: Very frequent (HP:0040281). (ORPHA:567)
- Abnormal facial shape (HP:0001999): An abnormal morphology (form) of the face or its components. Evidence: TAS. Frequency: Very frequent (HP:0040281). (ORPHA:567)
- Aphasia (HP:0002381): An acquired language impairment of some or all of the abilities to produce or comprehend speech and to read or write. Evidence: TAS. Frequency: Very frequent (HP:0040281). (ORPHA:567)
- Platybasia (HP:0002691): A developmental malformation of the occipital bone and upper end of the cervical spine, in which the latter appears to have pushed the floor of the occipital bone upward such that there is an abnormal flattening of the skull base. Evidence: TAS. Frequency: Very frequent (HP:0040281). (ORPHA:567)
- Immunodeficiency (HP:0002721): Failure of the immune system to protect the body adequately from infection, due to the absence or insufficiency of some component process or substance. Evidence: TAS. Frequency: Very frequent (HP:0040281). (ORPHA:567)
- Abnormal aortic arch morphology (HP:0012303): An anomaly of the arch of aorta. Evidence: TAS. Frequency: Very frequent (HP:0040281). (ORPHA:567)
- Abnormal cardiovascular system morphology (HP:0030680): Any structural anomaly of the heart and blood vessels. Evidence: TAS. Frequency: Very frequent (HP:0040281). (ORPHA:567)
- Renal hypoplasia (HP:0000089): Hypoplasia of the kidney. Evidence: TAS. Frequency: Frequent (HP:0040282). (ORPHA:567)
- Abnormality of the dentition (HP:0000164): Any abnormality of the teeth. Evidence: TAS. Frequency: Frequent (HP:0040282). (ORPHA:567)
- Malar flattening (HP:0000272): Underdevelopment of the malar prominence of the jugal bone (zygomatic bone in mammals), appreciated in profile, frontal view, and/or by palpation. Evidence: TAS. Frequency: Frequent (HP:0040282). (ORPHA:567)
- Long face (HP:0000276): Facial height (length) is more than 2 standard deviations above the mean (objective); or, an apparent increase in the height (length) of the face (subjective). Evidence: TAS. Frequency: Frequent (HP:0040282). (ORPHA:567)
- Long philtrum (HP:0000343): Distance between nasal base and midline upper lip vermilion border more than 2 SD above the mean. Alternatively, an apparently increased distance between nasal base and midline upper lip vermilion border. Evidence: TAS. Frequency: Frequent (HP:0040282). (ORPHA:567)
- Hearing impairment (HP:0000365): A decreased magnitude of the sensory perception of sound. Evidence: TAS. Frequency: Frequent (HP:0040282). (ORPHA:567)
- Small earlobe (HP:0000385): Reduced volume of the earlobe. Evidence: TAS. Frequency: Frequent (HP:0040282). (ORPHA:567)
- Chronic otitis media (HP:0000389): Chronic otitis media refers to fluid, swelling, or infection of the middle ear that does not heal and may cause permanent damage to the ear. Evidence: TAS. Frequency: Frequent (HP:0040282). (ORPHA:567)
- Overfolded helix (HP:0000396): A condition in which the helix is folded over to a greater degree than normal. That is, excessive curling of the helix edge, whereby the free edge is parallel to the plane of the ear. Evidence: TAS. Frequency: Frequent (HP:0040282). (ORPHA:567)
- Short neck (HP:0000470): Diminished length of the neck. Evidence: TAS. Frequency: Frequent (HP:0040282). (ORPHA:567)
- Abnormal eyelid morphology (HP:0000492): An abnormality of the eyelids. Evidence: TAS. Frequency: Frequent (HP:0040282). (ORPHA:567)
- Ptosis (HP:0000508): The upper eyelid margin is positioned 3 mm or more lower than usual and covers the superior portion of the iris (objective); or, the upper lid margin obscures at least part of the pupil (subjective). Evidence: TAS. Frequency: Frequent (HP:0040282). (ORPHA:567)
- Posterior embryotoxon (HP:0000627): A posterior embryotoxon is the presence of a prominent and anteriorly displaced line of Schwalbe. Evidence: TAS. Frequency: Frequent (HP:0040282). (ORPHA:567)
- Carious teeth (HP:0000670): Caries is a multifactorial bacterial infection affecting the structure of the tooth. This term has been used to describe the presence of more than expected dental caries. Evidence: TAS. Frequency: Frequent (HP:0040282). (ORPHA:567)
- Anxiety (HP:0000739): Intense feelings of nervousness, tension, or panic often arise in response to interpersonal stresses. There is worry about the negative effects of past unpleasant experiences and future negative possibilities. Individuals may feel fearful, apprehensive, or threatened by uncertainty, and they may also have fears of falling apart or losing control. Evidence: TAS. Frequency: Frequent (HP:0040282). (ORPHA:567)
- Hypoparathyroidism (HP:0000829): A condition caused by a deficiency of parathyroid hormone characterized by hypocalcemia and hyperphosphatemia. Evidence: TAS. Frequency: Frequent (HP:0040282). (ORPHA:567)
- Abnormal skull morphology (HP:0000929): An abnormality of the skull, the bony framework of the head which is comprised of the neurocranium (with eight cranial bones) and the viscerocranium (facial skeleton) that comprises fourteen facial bones with the mandible as its largest bone. Evidence: TAS. Frequency: Frequent (HP:0040282). (ORPHA:567)
- Seborrheic dermatitis (HP:0001051): Seborrheic dermatitis is a form of eczema which is closely related to dandruff. It causes dry or greasy peeling of the scalp, eyebrows, and face, and sometimes trunk. Evidence: TAS. Frequency: Frequent (HP:0040282). (ORPHA:567)
- Acne (HP:0001061): A skin condition in which there is an increase in sebum secretion by the pilosebaceous apparatus associated with open comedones (blackheads), closed comedones (whiteheads), and pustular nodules (papules, pustules, and cysts). Evidence: TAS. Frequency: Frequent (HP:0040282). (ORPHA:567)
- Arachnodactyly (HP:0001166): Abnormally long and slender fingers (spider fingers). Evidence: TAS. Frequency: Frequent (HP:0040282). (ORPHA:567)
- Mild intellectual disability (HP:0001256): Mild intellectual disability (ID) is defined as a type of ID characterized by mildly sub-average adaptive functioning and intellectual functioning, with an intelligence quotient (IQ) the range of 50-69. Evidence: TAS. Frequency: Frequent (HP:0040282). (ORPHA:567)
- Global developmental delay (HP:0001263): A delay in the achievement of motor or mental milestones in the domains of development of a child, including motor skills, speech and language, cognitive skills, and social and emotional skills. This term should only be used to describe children younger than five years of age. Evidence: TAS. Frequency: Frequent (HP:0040282). (ORPHA:567)
- Tetany (HP:0001281): A condition characterized by intermittent involuntary contraction of muscles (spasms) related to hypocalcemia or occasionally magnesium deficiency. Evidence: TAS. Frequency: Frequent (HP:0040282). (ORPHA:567)
- Specific learning disability (HP:0001328): Impairment of certain skills such as reading or writing, coordination, self-control, or attention that interfere with the ability to learn. The impairment is not related to a global deficiency of intelligence. Evidence: TAS. Frequency: Frequent (HP:0040282). (ORPHA:567)
- Constipation (HP:0002019): Infrequent or difficult evacuation of feces. Evidence: TAS. Frequency: Frequent (HP:0040282). (ORPHA:567)
- Meningocele (HP:0002435): Protrusion of the meninges through a defect of the skull or vertebral column. Evidence: TAS. Frequency: Frequent (HP:0040282). (ORPHA:567)
- Scoliosis (HP:0002650): The presence of an abnormal lateral curvature of the spine. Evidence: TAS. Frequency: Frequent (HP:0040282). (ORPHA:567)
- Hypocalcemia (HP:0002901): The concentration of calcium in the blood circulation is below the lower limit of normal. Evidence: TAS. Frequency: Frequent (HP:0040282). (ORPHA:567)
- Myalgia (HP:0003326): Pain in muscle. Evidence: TAS. Frequency: Frequent (HP:0040282). (ORPHA:567)
- Short stature (HP:0004322): A height below that which is expected according to age and gender norms. Although there is no universally accepted definition of short stature, many refer to "short stature" as height more than 2 standard deviations below the mean for age and gender (or below the 3rd percentile for age and gender dependent norms). Evidence: TAS. Frequency: Frequent (HP:0040282). (ORPHA:567)
- Attention deficit hyperactivity disorder (HP:0007018): Attention deficit hyperactivity disorder (ADHD) manifests at age 2-3 years or by first grade at the latest. The main symptoms are distractibility, impulsivity, hyperactivity, and often trouble organizing tasks and projects, difficulty going to sleep, and social problems from being aggressive, loud, or impatient. Evidence: TAS. Frequency: Frequent (HP:0040282). (ORPHA:567)
- Corneal neovascularization (HP:0011496): Ingrowth of new blood vessels into the cornea. Evidence: TAS. Frequency: Frequent (HP:0040282). (ORPHA:567)
- Anorectal anomaly (HP:0012732): An abnormality of the anus or rectum. Evidence: TAS. Frequency: Frequent (HP:0040282). (ORPHA:567)
- Abnormality of the tonsils (HP:0100765): An abnormality of the tonsils. Evidence: TAS. Frequency: Frequent (HP:0040282). (ORPHA:567)
- Inguinal hernia (HP:0000023): Protrusion of the contents of the abdominal cavity through the inguinal canal. Evidence: TAS. Frequency: Occasional (HP:0040283). (ORPHA:567)
- Cryptorchidism (HP:0000028): Testis in inguinal canal. That is, absence of one or both testes from the scrotum owing to failure of the testis or testes to descend through the inguinal canal to the scrotum. Evidence: TAS. Frequency: Occasional (HP:0040283). (ORPHA:567)
- Hypospadias (HP:0000047): Abnormal position of urethral meatus on the ventral penile shaft (underside) characterized by displacement of the urethral meatus from the tip of the glans penis to the ventral surface of the penis, scrotum, or perineum. Evidence: TAS. Frequency: Occasional (HP:0040283). (ORPHA:567)
- Vesicoureteral reflux (HP:0000076): Abnormal (retrograde) movement of urine from the bladder into ureters or kidneys related to inadequacy of the valvular mechanism at the ureterovesicular junction or other causes. Evidence: TAS. Frequency: Occasional (HP:0040283). (ORPHA:567)
- Polycystic kidney dysplasia (HP:0000113): The presence of multiple cysts in both kidneys. Evidence: TAS. Frequency: Occasional (HP:0040283). (ORPHA:567)
- Abnormality of the uterus (HP:0000130): An abnormality of the uterus. Evidence: TAS. Frequency: Occasional (HP:0040283). (ORPHA:567)
- Narrow mouth (HP:0000160): Distance between the commissures of the mouth more than 2 SD below the mean. Alternatively, an apparently decreased width of the oral aperture (subjective). Evidence: TAS. Frequency: Occasional (HP:0040283). (ORPHA:567)
- Hydrocephalus (HP:0000238): Hydrocephalus is an active distension of the ventricular system of the brain resulting from inadequate passage of CSF from its point of production within the cerebral ventricles to its point of absorption into the systemic circulation. Evidence: TAS. Frequency: Occasional (HP:0040283). (ORPHA:567)
- Microcephaly (HP:0000252): Head circumference below 2 standard deviations below the mean for age and gender. Evidence: TAS. Frequency: Occasional (HP:0040283). (ORPHA:567)
- Turricephaly (HP:0000262): Tall head relative to width and length. Evidence: TAS. Frequency: Occasional (HP:0040283). (ORPHA:567)
- Hypertelorism (HP:0000316): Interpupillary distance more than 2 SD above the mean (alternatively, the appearance of an increased interpupillary distance or widely spaced eyes). Evidence: TAS. Frequency: Occasional (HP:0040283). (ORPHA:567)
- Short philtrum (HP:0000322): Distance between nasal base and midline upper lip vermilion border more than 2 SD below the mean. Alternatively, an apparently decreased distance between nasal base and midline upper lip vermilion border. Evidence: TAS. Frequency: Occasional (HP:0040283). (ORPHA:567)
- Micrognathia (HP:0000347): Developmental hypoplasia of the mandible. Evidence: TAS. Frequency: Occasional (HP:0040283). (ORPHA:567)
- Choanal atresia (HP:0000453): Absence or abnormal closure of the choana (the posterior nasal aperture). Most embryologists believe that posterior choanal atresia results from a failure of rupture between the 35th and 38th day of fetal life of the partition which separates the bucconasal or buccopharyngeal membranes. The resultant choanal atresia may be unilateral or bilateral, bony or membranous, complete or incomplete. In over 90 per cent of cases the obstruction is bony, while in the remainder it is membranous. The bony type of atresia is commonly located 1-2 mm. anterior to the posterior edge of the hard palate, and the osseous septum varies in thickness from 1 to 10 mm. In the membranous form of choanal atresia the obstruction usually occurs further posteriorly. In approximately one third of cases the atresia is bilateral. Evidence: TAS. Frequency: Occasional (HP:0040283). (ORPHA:567)
- Strabismus (HP:0000486): A misalignment of the eyes so that the visual axes deviate from bifoveal fixation. The classification of strabismus may be based on a number of features including the relative position of the eyes, whether the deviation is latent or manifest, intermittent or constant, concomitant or otherwise and according to the age of onset and the relevance of any associated refractive error. Evidence: TAS. Frequency: Occasional (HP:0040283). (ORPHA:567)
- Downslanted palpebral fissures (HP:0000494): The palpebral fissure inclination is more than two standard deviations below the mean. Evidence: TAS. Frequency: Occasional (HP:0040283). (ORPHA:567)
- Glaucoma (HP:0000501): Glaucoma refers loss of retinal ganglion cells in a characteristic pattern of optic neuropathy usually associated with increased intraocular pressure. Evidence: TAS. Frequency: Occasional (HP:0040283). (ORPHA:567)
- Cataract (HP:0000518): A cataract is an opacity or clouding that develops in the crystalline lens of the eye or in its capsule. Evidence: TAS. Frequency: Occasional (HP:0040283). (ORPHA:567)
- Microphthalmia (HP:0000568): A developmental anomaly characterized by abnormal smallness of one or both eyes. Evidence: TAS. Frequency: Occasional (HP:0040283). (ORPHA:567)
- Optic atrophy (HP:0000648): Atrophy of the optic nerve. Optic atrophy results from the death of the retinal ganglion cell axons that comprise the optic nerve and manifesting as a pale optic nerve on fundoscopy. Evidence: TAS. Frequency: Occasional (HP:0040283). (ORPHA:567)
- Abnormal dental enamel morphology (HP:0000682): An abnormality of the dental enamel. Evidence: TAS. Frequency: Occasional (HP:0040283). (ORPHA:567)
- Atypical behavior (HP:0000708): Atypical behavior is an abnormality in a person's actions that can be controlled or modulated by the will of the individual. While abnormal behaviors can be difficult to control, they are distinct from other abnormal actions that cannot be affected by the individual's will. Evidence: TAS. Frequency: Occasional (HP:0040283). (ORPHA:567)
- Depression (HP:0000716): Frequently experiencing feelings of being down, miserable, and/or hopeless; struggling to recover from these moods; having a pessimistic outlook on the future; feeling a pervasive sense of shame; having a low self-worth; experiencing thoughts of suicide and engaging in suicidal behavior. Evidence: TAS. Frequency: Occasional (HP:0040283). (ORPHA:567)
- Autism (HP:0000717): Autism is a neurodevelopmental disorder characterized by impaired social interaction and communication, and by restricted and repetitive behavior. Autism begins in childhood. It is marked by the presence of markedly abnormal or impaired development in social interaction and communication and a markedly restricted repertoire of activity and interest. Manifestations of the disorder vary greatly depending on the developmental level and chronological age of the individual (DSM-IV). Evidence: TAS. Frequency: Occasional (HP:0040283). (ORPHA:567)
- Abnormal thorax morphology (HP:0000765): Any abnormality of the thorax (the region of the body formed by the sternum, the thoracic vertebrae and the ribs). Evidence: TAS. Frequency: Occasional (HP:0040283). (ORPHA:567)
- Hypothyroidism (HP:0000821): Deficiency of thyroid hormone. Evidence: TAS. Frequency: Occasional (HP:0040283). (ORPHA:567)
- Hyperthyroidism (HP:0000836): An abnormality of thyroid physiology characterized by excessive secretion of the thyroid hormones thyroxine (i.e., T4) and/or 3,3',5-triiodo-L-thyronine zwitterion (i.e., triiodothyronine or T3). Evidence: TAS. Frequency: Occasional (HP:0040283). (ORPHA:567)
- Purpura (HP:0000979): Purpura (from Latin: purpura, meaning purple) is the appearance of red or purple discolorations on the skin that do not blanch on applying pressure. They are caused by bleeding underneath the skin. This term refers to an abnormally increased susceptibility to developing purpura. Purpura are larger than petechiae. Evidence: TAS. Frequency: Occasional (HP:0040283). (ORPHA:567)
- Hypopigmented skin patches (HP:0001053). Evidence: TAS. Frequency: Occasional (HP:0040283). (ORPHA:567)
- Cholelithiasis (HP:0001081): Hard, pebble-like deposits that form within the gallbladder. Evidence: TAS. Frequency: Occasional (HP:0040283). (ORPHA:567)
- Retinal arteriolar tortuosity (HP:0001136): The presence of an increased number of twists and turns of the retinal arterioles. Evidence: TAS. Frequency: Occasional (HP:0040283). (ORPHA:567)
- Hand polydactyly (HP:0001161): A kind of polydactyly characterized by the presence of a supernumerary finger or fingers. Evidence: TAS. Frequency: Occasional (HP:0040283). (ORPHA:567)
- Intellectual disability (HP:0001249): The term intellectual disability or intellectual developmental disorder is used to describe significantly sub-average intellectual and adaptive functioning based on clinical assessment and as measured by individually administered, appropriately normed, standardized and validated tests of intellectual functioning and adaptive behavior, with onset during the developmental period from infancy through adolescence. Evidence: TAS. Frequency: Occasional (HP:0040283). (ORPHA:567)
- Seizure (HP:0001250): A seizure is an intermittent abnormality of nervous system physiology characterized by a transient occurrence of signs and/or symptoms due to abnormal excessive or synchronous neuronal activity in the brain. Evidence: TAS. Frequency: Occasional (HP:0040283). (ORPHA:567)
- Parkinsonism (HP:0001300): Characteristic neurologic anomaly resulting from degeneration of dopamine-generating cells in the substantia nigra, a region of the midbrain, characterized clinically by shaking, rigidity, slowness of movement and difficulty with walking and gait. Evidence: TAS. Frequency: Occasional (HP:0040283). (ORPHA:567)
- Arthritis (HP:0001369): Inflammation of a joint. Evidence: TAS. Frequency: Occasional (HP:0040283). (ORPHA:567)
- Failure to thrive (HP:0001508): Failure to thrive (FTT) refers to a child whose physical growth is substantially below the norm. Evidence: TAS. Frequency: Occasional (HP:0040283). (ORPHA:567)
- Intrauterine growth retardation (HP:0001511): An abnormal restriction of fetal growth with fetal weight below the tenth percentile for gestational age. Evidence: TAS. Frequency: Occasional (HP:0040283). (ORPHA:567)
- Obesity (HP:0001513): Accumulation of substantial excess body fat. Evidence: TAS. Frequency: Occasional (HP:0040283). (ORPHA:567)
- Umbilical hernia (HP:0001537): Protrusion of abdominal contents through a defect in the abdominal wall musculature around the umbilicus. Skin and subcutaneous tissue overlie the defect. Evidence: TAS. Frequency: Occasional (HP:0040283). (ORPHA:567)
- Polyhydramnios (HP:0001561): The presence of excess amniotic fluid in the uterus during pregnancy. Evidence: TAS. Frequency: Occasional (HP:0040283). (ORPHA:567)
- Laryngomalacia (HP:0001601): Laryngomalacia is a congenital abnormality of the laryngeal cartilage in which the cartilage is floppy and prolapses over the larynx during inspiration. Evidence: TAS. Frequency: Occasional (HP:0040283). (ORPHA:567)
- Patent ductus arteriosus (HP:0001643): In utero, the ductus arteriosus (DA) serves to divert ventricular output away from the lungs and toward the placenta by connecting the main pulmonary artery to the descending aorta. A patent ductus arteriosus (PDA) in the first 3 days of life is a physiologic shunt in healthy term and preterm newborn infants, and normally is substantially closed within about 24 hours after bith and completely closed after about three weeks. Failure of physiologcal closure is referred to a persistent or patent ductus arteriosus (PDA). Depending on the degree of left-to-right shunting, PDA can have clinical consequences. Evidence: TAS. Frequency: Occasional (HP:0040283). (ORPHA:567)
- Abnormal aortic valve morphology (HP:0001646): Any abnormality of the aortic valve. Evidence: TAS. Frequency: Occasional (HP:0040283). (ORPHA:567)
- Splenomegaly (HP:0001744): Abnormal increased size of the spleen. Evidence: TAS. Frequency: Occasional (HP:0040283). (ORPHA:567)
- Talipes equinovarus (HP:0001762): Talipes equinovarus (also called clubfoot) typically has four main components: inversion and adduction of the forefoot; inversion of the heel and hindfoot; equinus (limitation of extension) of the ankle and subtalar joint; and internal rotation of the leg. Evidence: TAS. Frequency: Occasional (HP:0040283). (ORPHA:567)
- Foot polydactyly (HP:0001829): A kind of polydactyly characterized by the presence of a supernumerary toe or toes. Evidence: TAS. Frequency: Occasional (HP:0040283). (ORPHA:567)
- Abnormality of thrombocytes (HP:0001872): An abnormality of platelets. Evidence: TAS. Frequency: Occasional (HP:0040283). (ORPHA:567)
- Thrombocytopenia (HP:0001873): A reduction in the number of circulating thrombocytes. Evidence: TAS. Frequency: Occasional (HP:0040283). (ORPHA:567)
- Gastroesophageal reflux (HP:0002020): A condition in which the stomach contents leak backwards from the stomach into the esophagus through the lower esophageal sphincter. Evidence: TAS. Frequency: Occasional (HP:0040283). (ORPHA:567)
- Anal atresia (HP:0002023): Congenital absence of the anus, i.e., the opening at the bottom end of the intestinal tract. Evidence: TAS. Frequency: Occasional (HP:0040283). (ORPHA:567)
- Asthma (HP:0002099): Asthma is characterized by increased responsiveness of the tracheobronchial tree to multiple stimuli, leading to narrowing of the air passages with resultant dyspnea, cough, and wheezing. Evidence: TAS. Frequency: Occasional (HP:0040283). (ORPHA:567)
- Abnormal lung lobation (HP:0002101): A developmental defect in the formation of pulmonary lobes. Evidence: TAS. Frequency: Occasional (HP:0040283). (ORPHA:567)
- Arrhinencephaly (HP:0002139): A defect of development of the brain characterized by congenital absence of the part of the brain that includes the olfactory bulbs, tracts, and other structures associated with the sense of smell. Evidence: TAS. Frequency: Occasional (HP:0040283). (ORPHA:567)
- Gastrointestinal hemorrhage (HP:0002239): Hemorrhage affecting the gastrointestinal tract. Evidence: TAS. Frequency: Occasional (HP:0040283). (ORPHA:567)
- Aganglionic megacolon (HP:0002251): An abnormality resulting from a lack of intestinal ganglion cells (i.e., an aganglionic section of bowel) that results in bowel obstruction with enlargement of the colon. Evidence: TAS. Frequency: Occasional (HP:0040283). (ORPHA:567)
- Spina bifida (HP:0002414): Incomplete closure of the embryonic neural tube, whereby some vertebral arches remain unfused and open. The mildest form is spina bifida occulta, followed by meningocele and meningomyelocele. Evidence: TAS. Frequency: Occasional (HP:0040283). (ORPHA:567)
- Intestinal malrotation (HP:0002566): An abnormality of the intestinal rotation and fixation that normally occurs during the development of the gut. This can lead to volvulus, or twisting of the intestine that causes obstruction and necrosis. Evidence: TAS. Frequency: Occasional (HP:0040283). (ORPHA:567)
- Bowel incontinence (HP:0002607): Involuntary fecal soiling in adults and children who have usually already been toilet trained. Evidence: TAS. Frequency: Occasional (HP:0040283). (ORPHA:567)
- Varicose veins (HP:0002619): Enlarged and tortuous veins. Evidence: TAS. Frequency: Occasional (HP:0040283). (ORPHA:567)
- Autoimmunity (HP:0002960): The occurrence of an immune reaction against the organism's own cells or tissues. Evidence: TAS. Frequency: Occasional (HP:0040283). (ORPHA:567)
- Patellar dislocation (HP:0002999): The kneecap normally is located within the groove termed trochlea on the distal femur and can slide up and down in it. Patellar dislocation occurs if the patella fully dislocates out of the groove. Evidence: TAS. Frequency: Occasional (HP:0040283). (ORPHA:567)
- Multiple renal cysts (HP:0005562): The presence of many cysts in the kidney. Evidence: TAS. Frequency: Occasional (HP:0040283). (ORPHA:567)
- Chronic pulmonary obstruction (HP:0006510): An anomaly that is characterized progressive airflow obstruction that is only partly reversible, inflammation in the airways, and systemic effects or comorbities. Evidence: TAS. Frequency: Occasional (HP:0040283). (ORPHA:567)
- Bipolar affective disorder (HP:0007302): Bipolar disorder is an illness of mood characterized by alternating episodes of elevated and depressed moods, which are interspersed with euthymic periods. Evidence: TAS. Frequency: Occasional (HP:0040283). (ORPHA:567)
- Feeding difficulties in infancy (HP:0008872): Impaired feeding performance of an infant as manifested by difficulties such as weak and ineffective sucking, brief bursts of sucking, and falling asleep during sucking. There may be difficulties with chewing or maintaining attention. Evidence: TAS. Frequency: Occasional (HP:0040283). (ORPHA:567)
- Multiple suture craniosynostosis (HP:0011324): Craniosynostosis involving at least 2 cranial sutures, where the exact pattern of sutures fused has not been precisely specified. Evidence: TAS. Frequency: Occasional (HP:0040283). (ORPHA:567)
- Tricuspid atresia (HP:0011662): Failure to develop of the tricuspid valve and thus lack of the normal connection between the right atrium and the right ventricle. Evidence: TAS. Frequency: Occasional (HP:0040283). (ORPHA:567)
- Hypertensive crisis (HP:0100735). Evidence: TAS. Frequency: Occasional (HP:0040283). (ORPHA:567)
- Atelectasis (HP:0100750): Collapse of part of a lung associated with absence of inflation (air) of that part. Evidence: TAS. Frequency: Occasional (HP:0040283). (ORPHA:567)
- Schizophrenia (HP:0100753): A mental disorder characterized by a disintegration of thought processes and emotional responsiveness. It most commonly manifests as auditory hallucinations, paranoid or bizarre delusions, or disorganized speech and thinking. It is accompanied by significant social or occupational dysfunction. The onset of symptoms typically occurs in young adulthood, with a global lifetime prevalence of about 1%. This term is not a helpful parent term to describe abnormal experiences. Evidence: TAS. Frequency: Occasional (HP:0040283). (ORPHA:567)